Phenotypes associated with the disease premature chromatid separation trait (OMIM:176430):
- Premature chromatid separation (HP:0200024): The presence of premature sister chromatid segregation. Evidence: IEA. (OMIM:176430)
- Autosomal dominant inheritance (HP:0000006): A mode of inheritance that is observed for traits related to a gene encoded on one of the autosomes (i.e., the human chromosomes 1-22) in which a trait manifests in heterozygotes. In the context of medical genetics, an autosomal dominant disorder is caused when a single copy of the mutant allele is present. Males and females are affected equally, and can both transmit the disorder with a risk of 50% for each child of inheriting the mutant allele. Evidence: IEA. (OMIM:176430)